Phenotypes associated with the disease atrial fibrillation, familial, 14 (OMIM:615378):
- Middle age onset (HP:0003596): A type of adult onset with onset of symptoms at the age of 40 to 60 years. Evidence: PCS. Frequency: 2/2. (PMID:19808477)
- ST segment elevation (HP:0012251): An electrocardiographic anomaly in which the ST segment is observed to be located superior to the isoelectric line. Evidence: PCS. Frequency: 2/2. (PMID:19808477)
- Hypertension (HP:0000822): The presence of chronic increased pressure in the systemic arterial system. Evidence: PCS. Frequency: 1/2. (PMID:19808477)
- Paroxysmal atrial fibrillation (HP:0004757): Episodes of atrial fibrillation that typically last for several hours up to one day and terminate spontaneously. Evidence: PCS. Frequency: 2/2. (PMID:19808477)
- Autosomal dominant inheritance (HP:0000006): A mode of inheritance that is observed for traits related to a gene encoded on one of the autosomes (i.e., the human chromosomes 1-22) in which a trait manifests in heterozygotes. In the context of medical genetics, an autosomal dominant disorder is caused when a single copy of the mutant allele is present. Males and females are affected equally, and can both transmit the disorder with a risk of 50% for each child of inheriting the mutant allele. Evidence: PCS. (PMID:19808477)
- Prolonged PR interval (HP:0012248): Increased time for the PR interval (beginning of the P wave to the beginning of the QRS complex). Evidence: PCS. Frequency: 1/2. (PMID:19808477)